Phenotypes associated with the disease intellectual disability, autosomal recessive 1 (OMIM:249500):
- Hyperactive deep tendon reflexes (HP:0006801). Evidence: TAS. (OMIM:249500)
- Strabismus (HP:0000486): A misalignment of the eyes so that the visual axes deviate from bifoveal fixation. The classification of strabismus may be based on a number of features including the relative position of the eyes, whether the deviation is latent or manifest, intermittent or constant, concomitant or otherwise and according to the age of onset and the relevance of any associated refractive error. Evidence: IEA. (OMIM:249500)
- Babinski sign (HP:0003487): Upturning of the big toe (and sometimes fanning of the other toes) in response to stimulation of the sole of the foot. If the Babinski sign is present it can indicate damage to the corticospinal tract. Evidence: TAS. (OMIM:249500)
- Nystagmus (HP:0000639): Rhythmic, involuntary oscillations of one or both eyes related to abnormality in fixation, conjugate gaze, or vestibular mechanisms. Evidence: IEA. (OMIM:249500)
- Childhood onset (HP:0011463): Onset of disease at the age of between 1 and 5 years. Evidence: PCS. Frequency: 5/5. (PMID:12459588)
- Increased circulating lactate concentration (HP:0002151): Abnormally increased level of blood lactate (2-hydroxypropanoic acid). Lactate is produced from pyruvate by lactate dehydrogenase during normal metabolism. The terms lactate and lactic acid are often used interchangeably but lactate (the component measured in blood) is strictly a weak base whereas lactic acid is the corresponding acid. Lactic acidosis is often used clinically to describe elevated lactate but should be reserved for cases where there is a corresponding acidosis (pH below 7.35). Evidence: PCS. Frequency: 0/4. (PMID:12459588)
- Autosomal recessive inheritance (HP:0000007): A mode of inheritance that is observed for traits related to a gene encoded on one of the autosomes (i.e., the human chromosomes 1-22) in which a trait manifests in individuals with two pathogenic alleles, either homozygotes (two copies of the same mutant allele) or compound heterozygotes (whereby each copy of a gene has a distinct mutant allele). Evidence: PCS. (PMID:12459588)
- Severe intellectual disability (HP:0010864): Severe intellectual disability (ID) is defined as a type of ID characterized by severely sub-average adaptive functioning and intellectual functioning, with an intelligence quotient (IQ) the range of 20-34. Evidence: PCS. Frequency: 5/5. (PMID:12459588)